Phenotypes associated with the disease Sensory ataxic neuropathy-dysarthria-ophthalmoparesis syndrome (ORPHA:70595):
- Ptosis (HP:0000508): The upper eyelid margin is positioned 3 mm or more lower than usual and covers the superior portion of the iris (objective); or, the upper lid margin obscures at least part of the pupil (subjective). Evidence: TAS. Frequency: Frequent (HP:0040282). (ORPHA:70595)
- Ophthalmoparesis (HP:0000597): Ophthalmoplegia is a paralysis or weakness of one or more of the muscles that control eye movement. Evidence: TAS. Frequency: Frequent (HP:0040282). (ORPHA:70595)
- Nystagmus (HP:0000639): Rhythmic, involuntary oscillations of one or both eyes related to abnormality in fixation, conjugate gaze, or vestibular mechanisms. Evidence: TAS. Frequency: Frequent (HP:0040282). (ORPHA:70595)
- Dysarthria (HP:0001260): Dysarthric speech is a general description referring to a neurological speech disorder characterized by poor articulation. Depending on the involved neurological structures, dysarthria may be further classified as spastic, flaccid, ataxic, hyperkinetic and hypokinetic, or mixed. Evidence: TAS. Frequency: Frequent (HP:0040282). (ORPHA:70595)
- Hyporeflexia (HP:0001265): Reduction of neurologic reflexes such as the knee-jerk reaction. Evidence: TAS. Frequency: Frequent (HP:0040282). (ORPHA:70595)
- Myoclonus (HP:0001336): Very brief, involuntary random muscular contractions occurring at rest, in response to sensory stimuli, or accompanying voluntary movements. Evidence: TAS. Frequency: Frequent (HP:0040282). (ORPHA:70595)
- Abnormal vestibular function (HP:0001751): An abnormality of the functioning of the vestibular apparatus. Evidence: TAS. Frequency: Frequent (HP:0040282). (ORPHA:70595)
- Gait ataxia (HP:0002066): A type of ataxia characterized by the impairment of the ability to coordinate the movements required for normal walking. Gait ataxia is characteirzed by a wide-based staggering gait with a tendency to fall. Evidence: TAS. Frequency: Frequent (HP:0040282). (ORPHA:70595)
- Increased circulating lactate concentration (HP:0002151): Abnormally increased level of blood lactate (2-hydroxypropanoic acid). Lactate is produced from pyruvate by lactate dehydrogenase during normal metabolism. The terms lactate and lactic acid are often used interchangeably but lactate (the component measured in blood) is strictly a weak base whereas lactic acid is the corresponding acid. Lactic acidosis is often used clinically to describe elevated lactate but should be reserved for cases where there is a corresponding acidosis (pH below 7.35). Evidence: TAS. Frequency: Frequent (HP:0040282). (ORPHA:70595)
- Positive Romberg sign (HP:0002403): The patient stands with the feet placed together and balance and is asked to close his or her eyes. A loss of balance upon eye closure is a positive Romberg sign and is interpreted as indicating a deficit in proprioception. Evidence: TAS. Frequency: Frequent (HP:0040282). (ORPHA:70595)
- Impaired vibratory sensation (HP:0002495): A decrease in the ability to perceive vibration. Clinically, this is usually tested with a tuning fork which vibrates at 128 Hz and is applied to bony prominences such as the malleoli at the ankles or the metacarpal-phalangeal joints. There is a slow decay of vibration from the tuning fork. The degree of vibratory sense loss can be crudely estimated by counting the number of seconds that the examiner can perceive the vibration longer than the patient. Evidence: TAS. Frequency: Frequent (HP:0040282). (ORPHA:70595)
- Ragged-red muscle fibers (HP:0003200): An abnormal appearance of muscle fibers observed on muscle biopsy. Ragged red fibers can be visualized with Gomori trichrome staining as irregular and intensely red subsarcolemmal zones, whereas the normal myofibrils are green. The margins of affect fibers appear red and ragged. The ragged-red is due to the accumulation of abnormal mitochondria below the plasma membrane of the muscle fiber, leading to the appearance of a red rim and speckled sarcoplasm. Evidence: TAS. Frequency: Frequent (HP:0040282). (ORPHA:70595)
- Sensory ataxic neuropathy (HP:0003434). Evidence: TAS. Frequency: Frequent (HP:0040282). (ORPHA:70595)
- Increased variability in muscle fiber diameter (HP:0003557): An abnormally high degree of muscle fiber size variation. This phenotypic feature can be observed upon muscle biopsy. Evidence: TAS. Frequency: Frequent (HP:0040282). (ORPHA:70595)
- Proximal muscle weakness (HP:0003701): A lack of strength of the proximal muscles. Evidence: TAS. Frequency: Frequent (HP:0040282). (ORPHA:70595)
- Impaired distal proprioception (HP:0006858): A loss or impairment of the sensation of the relative position of parts of the body and joint position occurring at distal joints. Evidence: TAS. Frequency: Frequent (HP:0040282). (ORPHA:70595)
- Atrophy/Degeneration involving the spinal cord (HP:0007344). Evidence: TAS. Frequency: Frequent (HP:0040282). (ORPHA:70595)
- Bilateral sensorineural hearing impairment (HP:0008619): A form of sensorineural hearing impairment that affects both ears. Evidence: TAS. Frequency: Frequent (HP:0040282). (ORPHA:70595)
- Abnormal thalamic MRI signal intensity (HP:0012696): A deviation from normal signal on magnetic resonance imaging (MRI) of the thalamus. Evidence: TAS. Frequency: Frequent (HP:0040282). (ORPHA:70595)
- Upgaze palsy (HP:0025331): A limitation of the ability to direct one's gaze above the horizontal meridian. Evidence: TAS. Frequency: Frequent (HP:0040282). (ORPHA:70595)
- Abnormal cerebellar cortex morphology (HP:0031422): Any structural anomaly of the cortex of the cerebellum. Evidence: TAS. Frequency: Frequent (HP:0040282). (ORPHA:70595)
- Cataract (HP:0000518): A cataract is an opacity or clouding that develops in the crystalline lens of the eye or in its capsule. Evidence: TAS. Frequency: Occasional (HP:0040283). (ORPHA:70595)
- Depression (HP:0000716): Frequently experiencing feelings of being down, miserable, and/or hopeless; struggling to recover from these moods; having a pessimistic outlook on the future; feeling a pervasive sense of shame; having a low self-worth; experiencing thoughts of suicide and engaging in suicidal behavior. Evidence: TAS. Frequency: Occasional (HP:0040283). (ORPHA:70595)
- Seizure (HP:0001250): A seizure is an intermittent abnormality of nervous system physiology characterized by a transient occurrence of signs and/or symptoms due to abnormal excessive or synchronous neuronal activity in the brain. Evidence: TAS. Frequency: Occasional (HP:0040283). (ORPHA:70595)
- Areflexia (HP:0001284): Absence of neurologic reflexes such as the knee-jerk reaction. Evidence: TAS. Frequency: Occasional (HP:0040283). (ORPHA:70595)
- Dilated cardiomyopathy (HP:0001644): Dilated cardiomyopathy (DCM) is defined by the presence of left ventricular dilatation and left ventricular systolic dysfunction in the absence of abnormal loading conditions (hypertension, valve disease) or coronary artery disease sufficient to cause global systolic impairment. Right ventricular dilation and dysfunction may be present but are not necessary for the diagnosis. Evidence: TAS. Frequency: Occasional (HP:0040283). (ORPHA:70595)
- Migraine (HP:0002076): Migraine is a chronic neurological disorder characterized by episodic attacks of headache and associated symptoms. Evidence: TAS. Frequency: Occasional (HP:0040283). (ORPHA:70595)
- Memory impairment (HP:0002354): An impairment of memory as manifested by a reduced ability to remember things such as dates and names, and increased forgetfulness. Evidence: TAS. Frequency: Occasional (HP:0040283). (ORPHA:70595)
- Gastroparesis (HP:0002578): Decreased strength of the muscle layer of stomach, which leads to a decreased ability to empty the contents of the stomach despite the absence of obstruction. Evidence: TAS. Frequency: Occasional (HP:0040283). (ORPHA:70595)
- Intestinal pseudo-obstruction (HP:0004389): A functional rather than mechanical obstruction of the intestines, associated with manifestations that resemble those caused by an intestinal obstruction, including distension, abdominal pain, nausea, vomiting, constipation or diarrhea, in an individual in whom a mechanical blockage has been excluded. Evidence: TAS. Frequency: Occasional (HP:0040283). (ORPHA:70595)
- Cognitive impairment (HP:0100543): Abnormal cognition is characterized by deficits in thinking, reasoning, or remembering. Evidence: TAS. Frequency: Occasional (HP:0040283). (ORPHA:70595)